Phenotypes associated with the disease retinitis pigmentosa 35 (OMIM:610282):
- Nyctalopia (HP:0000662): Inability to see well at night or in poor light. Evidence: PCS. (PMID:16199541)
- Blindness (HP:0000618): Blindness is the condition of lacking visual perception defined as a profound reduction in visual perception. On the 6m visual acuity scale, blindness is defined as less than 3/60. On the 20ft visual acuity scale, blindness is defined as less than 20/400. On the decimal visual acuity scale, blindness is defined as less than 0.05. Blindness is typically characterized by a visual field of no greater than 10 degrees in radius around central fixation. Evidence: PCS. (PMID:16199541)
- Autosomal recessive inheritance (HP:0000007): A mode of inheritance that is observed for traits related to a gene encoded on one of the autosomes (i.e., the human chromosomes 1-22) in which a trait manifests in individuals with two pathogenic alleles, either homozygotes (two copies of the same mutant allele) or compound heterozygotes (whereby each copy of a gene has a distinct mutant allele). Evidence: PCS. (PMID:16199541)
- Reduced visual acuity (HP:0007663). Evidence: PCS. (PMID:16199541)
- Rod-cone dystrophy (HP:0000510): An inherited retinal disease subtype in which the rod photoreceptors appear to be more severely affected than the cone photoreceptors. Typical presentation is with nyctalopia (due to rod dysfunction) followed by loss of mid-peripheral field of vision, which gradually extends and leaves many patients with a small central island of vision due to the preservation of macular cones. Evidence: PCS. (PMID:16199541)